- Pituitary carcinoma (HP:0011763): A pituitary tumor with subarachnoid, brain, or systemic metastasis. The diagnosis of a pituitary carcinoma requires evidence of metastatic disease, either outside the central nervous system (CNS) or as separate noncontiguous foci within the CNS. Evidence: TAS. Frequency: Obligate (HP:0040280). (ORPHA:300385)
- Increased circulating prolactin concentration (HP:0000870): The presence of abnormally increased levels of prolactin in the blood. Prolactin is a peptide hormone produced by the anterior pituitary gland that plays a role in breast development and lactation during pregnancy. Evidence: TAS. Frequency: Very frequent (HP:0040281). (ORPHA:300385)
- Headache (HP:0002315): Cephalgia, or pain sensed in various parts of the head, not confined to the area of distribution of any nerve. Evidence: TAS. Frequency: Very frequent (HP:0040281). (ORPHA:300385)
- Increased circulating ACTH level (HP:0003154): An abnormal increased in the concentration of corticotropin, also known as adrenocorticotropic hormone (ACTH), in the blood. Evidence: TAS. Frequency: Very frequent (HP:0040281). (ORPHA:300385)
- Pituitary prolactin cell adenoma (HP:0006767): A type of pituitary adenoma originating in prolactin secreting cells. This kind of adenoma is characterized by overproduction of prolactin, and may cause loss of menstrual periods and breast milk production in women. Evidence: TAS. Frequency: Very frequent (HP:0040281). (ORPHA:300385)
- Pituitary corticotropic cell adenoma (HP:0008291): A type of pituitary adenoma that produces adrenocorticotropic hormone (ACTH). Evidence: TAS. Frequency: Very frequent (HP:0040281). (ORPHA:300385)
- Malignant neoplasm of the central nervous system (HP:0100836): A tumor that originates in the pineal gland, has moderate cellularity and tends to form rosette patterns. Evidence: TAS. Frequency: Very frequent (HP:0040281). (ORPHA:300385)
- Reduced visual acuity (HP:0007663). Evidence: TAS. Frequency: Frequent (HP:0040282). (ORPHA:300385)
- Progressive visual field defects (HP:0007987). Evidence: TAS. Frequency: Frequent (HP:0040282). (ORPHA:300385)
- Hemianopia (HP:0012377): Partial or complete loss of vision in one half of the visual field of one or both eyes. Evidence: TAS. Frequency: Frequent (HP:0040282). (ORPHA:300385)
- Enlarged pituitary gland (HP:0012505): An abnormally increased size of the pituitary gland. Evidence: TAS. Frequency: Frequent (HP:0040282). (ORPHA:300385)
- Hypopituitarism (HP:0040075). Evidence: TAS. Frequency: Frequent (HP:0040282). (ORPHA:300385)
- Hearing impairment (HP:0000365): A decreased magnitude of the sensory perception of sound. Evidence: TAS. Frequency: Occasional (HP:0040283). (ORPHA:300385)
- Elevated circulating growth hormone concentration (HP:0000845): Acromegaly is a condition resulting from overproduction of growth hormone by the pituitary gland in persons with closed epiphyses, and consists chiefly in the enlargement of the distal parts of the body. The circumference of the skull increases, the nose becomes broad, the tongue becomes enlarged, the facial features become coarsened, the mandible grows excessively, and the teeth become separated. The fingers and toes grow chiefly in thickness. Evidence: TAS. Frequency: Occasional (HP:0040283). (ORPHA:300385)
- Ataxia (HP:0001251): Ataxia refers to impaired coordination of voluntary muscle movement. Cerebellar ataxia refers to ataxia due to dysfunction of the cerebellum. This causes a variety of elementary neurological deficits including asynergy (lack of coordination between muscles, limbs and joints), dysmetria (lack of ability to judge distances that can lead to under- or overshoot in grasping movements), and dysdiadochokinesia (inability to perform rapid movements requiring antagonizing muscle groups to be switched on and off repeatedly). Evidence: TAS. Frequency: Occasional (HP:0040283). (ORPHA:300385)
- Hyperpituitarism (HP:0010514): Hypersecretion of one or more pituitary hormones. This can occur in conditions in which deficiency in the target organ leads to decreased hormonal feedback, or as a primary condition most usually in connection with a pituitary adenoma. Evidence: TAS. Frequency: Occasional (HP:0040283). (ORPHA:300385)
- Abnormal central motor function (HP:0011442): An anomaly of the control or production of movement in the central nervous system. Evidence: TAS. Frequency: Occasional (HP:0040283). (ORPHA:300385)
- Pituitary growth hormone cell adenoma (HP:0011760): A type of pituitary adenoma that produces growth hormone. Evidence: TAS. Frequency: Occasional (HP:0040283). (ORPHA:300385)
- Spinal cord lesion (HP:0100561). Evidence: TAS. Frequency: Occasional (HP:0040283). (ORPHA:300385)
- Diabetes insipidus (HP:0000873): A state of excessive water intake and hypotonic (dilute) polyuria. Diabetes insipidus may be due to failure of vasopressin (AVP) release (central or neurogenic diabetes insipidus) or to a failure of the kidney to respond to AVP (nephrogenic diabetes insipidus). Evidence: TAS. Frequency: Very rare (HP:0040284). (ORPHA:300385)
- Pituitary gonadotropic cell adenoma (HP:0011759): A type of pituitary adenoma that produces gonadotropins. Evidence: TAS. Frequency: Very rare (HP:0040284). (ORPHA:300385)
- Pituitary thyrotropic cell adenoma (HP:0011762): A type of pituitary adenoma that produces thyroid stimulating hormone (TSH). Evidence: TAS. Frequency: Very rare (HP:0040284). (ORPHA:300385)
These phenotypes are associated with the disease Pituitary carcinoma (ORPHA:300385).